Phenotypes associated with the disease autosomal dominant nonsyndromic hearing loss 64 (OMIM:614152):
- Progressive (HP:0003676): Applies to a disease manifestation that increases in scope or severity over the course of time, i.e., that worsens with age. Evidence: PCS. (PMID:21722859)
- Juvenile onset (HP:0003621): Onset of signs or symptoms of disease between the age of 5 and 15 years. Evidence: PCS. (PMID:21722859)
- Sensorineural hearing impairment (HP:0000407): A type of hearing impairment in one or both ears related to an abnormal functionality of the cochlear nerve. Evidence: PCS. Frequency: 16/16. (PMID:21722859)
- Young adult onset (HP:0011462): Onset of disease at the age of between 16 and 40 years. Evidence: PCS. (PMID:21722859)
- Tinnitus (HP:0000360): Tinnitus is an auditory perception that can be described as the experience of sound, in the ear or in the head, in the absence of external acoustic stimulation. Evidence: PCS. Frequency: 12/16. (PMID:21722859)
- Autosomal dominant inheritance (HP:0000006): A mode of inheritance that is observed for traits related to a gene encoded on one of the autosomes (i.e., the human chromosomes 1-22) in which a trait manifests in heterozygotes. In the context of medical genetics, an autosomal dominant disorder is caused when a single copy of the mutant allele is present. Males and females are affected equally, and can both transmit the disorder with a risk of 50% for each child of inheriting the mutant allele. Evidence: PCS. (PMID:21722859)